Phenotypes associated with the disease Ovarian hyperstimulation syndrome (ORPHA:64739):
- Ovarian cyst (HP:0000138): The presence of one or more cysts of the ovary. Evidence: TAS. Frequency: Frequent (HP:0040282). (ORPHA:64739)
- Increased circulating gonadotropin level (HP:0000837): Overproduction of gonadotropins (FSH, LH) by the anterior pituitary gland. Evidence: TAS. Frequency: Very frequent (HP:0040281). (ORPHA:64739)
- Hirsutism (HP:0001007): Abnormally increased hair growth referring to a male pattern of body hair (androgenic hair). Evidence: TAS. Frequency: Very frequent (HP:0040281). (ORPHA:64739)
- Ascites (HP:0001541): Accumulation of fluid in the peritoneal cavity (between the layers of the peritoneum that lines the abdomen). Evidence: TAS. Frequency: Very frequent (HP:0040281). (ORPHA:64739)
- Nausea and vomiting (HP:0002017): Nausea is a commonly encountered symptom that has been defined as an unpleasant painless subjective feeling that one will imminently vomit. Vomiting has been defined as the forceful expulsion of the contents of the stomach, duodenum, or jejunum through the oral cavity. While nausea and vomiting are often thought to exist on a temporal continuum, this is not always the case. There are situations when severe nausea may be present without emesis and less frequently, when emesis may be present without preceding nausea. Evidence: TAS. Frequency: Very frequent (HP:0040281). (ORPHA:64739)
- Nausea (HP:0002018): A sensation of unease in the stomach together with an urge to vomit. Evidence: TAS. Frequency: Very frequent (HP:0040281). (ORPHA:64739)
- Abdominal pain (HP:0002027): An unpleasant sensation characterized by physical discomfort (such as pricking, throbbing, or aching) and perceived to originate in the abdomen. Evidence: TAS. Frequency: Very frequent (HP:0040281). (ORPHA:64739)
- Pleural effusion (HP:0002202): The presence of an excessive amount of fluid in the pleural cavity. Evidence: TAS. Frequency: Frequent (HP:0040282). (ORPHA:64739)
- Abdominal distention (HP:0003270): Distention of the abdomen. Evidence: TAS. Frequency: Very frequent (HP:0040281). (ORPHA:64739)
- Generalized edema (HP:0007430): Generalized abnormal accumulation of fluid beneath the skin, or in one or more cavities of the body. Evidence: TAS. Frequency: Occasional (HP:0040283). (ORPHA:64739)
- Enlarged polycystic ovaries (HP:0008675). Evidence: TAS. Frequency: Very frequent (HP:0040281). (ORPHA:64739)
- Hypovolemia (HP:0011106): An decrease in the amount of intravascular fluid, particularly in the volume of the circulating blood. Evidence: TAS. Frequency: Occasional (HP:0040283). (ORPHA:64739)
- Peripheral edema (HP:0012398): An abnormal accumulation of interstitial fluid in the soft tissues of the limbs. Evidence: TAS. Frequency: Occasional (HP:0040283). (ORPHA:64739)
- Increased serum testosterone level (HP:0030088): An elevated circulating testosterone level in the blood. Evidence: TAS. Frequency: Very frequent (HP:0040281). (ORPHA:64739)
- Hemorrhagic ovarian cyst (HP:0012886): An abdominal mass formed by bleeding into a follicular ovarian cyst or corpus luteum cyst. Evidence: TAS. Frequency: Frequent (HP:0040282). (ORPHA:64739)
- Capillary leak (HP:0030005): An acute phenomenon characterized by hypotension and anasarca due to the loss of plasma volume into peripheral tissues, with evidence of decreased plasma volume (hemoconcentration) and protein loss from the intravascular space (hypoalbuminemia) during acute episodes. Evidence: TAS. Frequency: Very frequent (HP:0040281). (ORPHA:64739)
- Pulmonary edema (HP:0100598): Fluid accumulation in the lungs. Evidence: TAS. Frequency: Occasional (HP:0040283). (ORPHA:64739)